- Exostoses (HP:0100777): An exostosis is a benign growth the projects outward from the bone surface. It is capped by cartilage, and arises from a bone that develops from cartilage. Evidence: IEA. (OMIM:133600)
- Abnormality of the skeletal system (HP:0000924): An abnormality of the skeletal system. Evidence: IEA. (OMIM:133600)
- Autosomal dominant inheritance (HP:0000006): A mode of inheritance that is observed for traits related to a gene encoded on one of the autosomes (i.e., the human chromosomes 1-22) in which a trait manifests in heterozygotes. In the context of medical genetics, an autosomal dominant disorder is caused when a single copy of the mutant allele is present. Males and females are affected equally, and can both transmit the disorder with a risk of 50% for each child of inheriting the mutant allele. Evidence: IEA. (OMIM:133600)
These phenotypes are associated with the disease Exostoses of heel (OMIM:133600).